Phenotypes associated with the disease granulomas, congenital cerebral (OMIM:306300):
- Abnormality of the nervous system (HP:0000707): An abnormality of the nervous system. Evidence: IEA. (OMIM:306300)
- Abnormality of metabolism/homeostasis (HP:0001939). Evidence: IEA. (OMIM:306300)
- Neonatal death (HP:0003811): Death within the first 28 days of life. Evidence: IEA. (OMIM:306300)